- Craniosynostosis (HP:0001363): Craniosynostosis refers to the premature closure of the cranial sutures. Primary craniosynostosis refers to the closure of one or more sutures due to abnormalities in skull development, and secondary craniosynostosis results from failure of brain growth. Evidence: PCS. Frequency: 2/2. (PMID:17651129)
- Autosomal dominant inheritance (HP:0000006): A mode of inheritance that is observed for traits related to a gene encoded on one of the autosomes (i.e., the human chromosomes 1-22) in which a trait manifests in heterozygotes. In the context of medical genetics, an autosomal dominant disorder is caused when a single copy of the mutant allele is present. Males and females are affected equally, and can both transmit the disorder with a risk of 50% for each child of inheriting the mutant allele. Evidence: PCS. (PMID:17651129)
These phenotypes are associated with the disease craniosynostosis 5, susceptibility to (OMIM:615529).